- Permanent atrial fibrillation (HP:0004754): Atrial fibrillation (AF) that cannot be successfully terminated by cardioversion, and longstanding (more than 1 year) AF, where cardioversion is not indicated or has not been attempted, is termed permanent. Evidence: PCS. (OMIM:108950)
- Paroxysmal atrial tachycardia (HP:0006671). Evidence: PCS. (OMIM:108950)
- Shortened PR interval (HP:0005165): Reduced time for the PR interval (beginning of the P wave to the beginning of the QRS complex). In adults, normal values are 120 to 200 ms long. Evidence: PCS. (OMIM:108950)
- Paroxysmal atrial fibrillation (HP:0004757): Episodes of atrial fibrillation that typically last for several hours up to one day and terminate spontaneously. Evidence: PCS. (OMIM:108950)
- Autosomal dominant inheritance (HP:0000006): A mode of inheritance that is observed for traits related to a gene encoded on one of the autosomes (i.e., the human chromosomes 1-22) in which a trait manifests in heterozygotes. In the context of medical genetics, an autosomal dominant disorder is caused when a single copy of the mutant allele is present. Males and females are affected equally, and can both transmit the disorder with a risk of 50% for each child of inheriting the mutant allele. Evidence: PCS. (OMIM:108950)
These phenotypes are associated with the disease Lown-Ganong-Levine syndrome (OMIM:108950).